Phenotypes associated with the disease Hyperphosphatasia-intellectual disability syndrome (ORPHA:247262):
- Hypertelorism (HP:0000316): Interpupillary distance more than 2 SD above the mean (alternatively, the appearance of an increased interpupillary distance or widely spaced eyes). Evidence: TAS. Frequency: Very frequent (HP:0040281). (ORPHA:247262)
- Seizure (HP:0001250): A seizure is an intermittent abnormality of nervous system physiology characterized by a transient occurrence of signs and/or symptoms due to abnormal excessive or synchronous neuronal activity in the brain. Evidence: TAS. Frequency: Very frequent (HP:0040281). (ORPHA:247262)
- Global developmental delay (HP:0001263): A delay in the achievement of motor or mental milestones in the domains of development of a child, including motor skills, speech and language, cognitive skills, and social and emotional skills. This term should only be used to describe children younger than five years of age. Evidence: TAS. Frequency: Very frequent (HP:0040281). (ORPHA:247262)
- Elevated circulating alkaline phosphatase concentration (HP:0003155): Abnormally increased serum levels of alkaline phosphatase activity. Evidence: TAS. Frequency: Very frequent (HP:0040281). (ORPHA:247262)
- Shortening of all distal phalanges of the fingers (HP:0006118): Hypoplasia of all of the distal phalanx of finger. Evidence: TAS. Frequency: Very frequent (HP:0040281). (ORPHA:247262)
- Floppy infant (HP:0008947): Floppiness/hypotonia is defined as reduced resistance to passive movement of joints. Physical examination of floppy/hypotonic infants shows head lag, lack of shoulder and elbow muscle contraction on traction response, inability to tighten the shoulder girdle muscles (or slipping through) when held under the axillae, scarf sign (when the arm is pulled to the opposite side, the arm wraps around the neck with the elbow crossing midline), hyperdorsiflexion of the feet, easy apposition of the thumb against the forearm, feet touching the cheek with ease and without discomfort, frog leg position, and inverted U sign on ventral suspension (head, arms, and legs hanging down without elbow or knee flexion and the trunk rounded in a dome shape). Evidence: TAS. Frequency: Very frequent (HP:0040281). (ORPHA:247262)
- Wide nasal bridge (HP:0000431): Increased breadth of the nasal bridge (and with it, the nasal root). Evidence: TAS. Frequency: Frequent (HP:0040282). (ORPHA:247262)
- Long palpebral fissure (HP:0000637): Distance between medial and lateral canthi is more than two standard deviations above the mean for age (objective); or, apparently increased length of the palpebral fissures. Evidence: TAS. Frequency: Frequent (HP:0040282). (ORPHA:247262)
- Intellectual disability (HP:0001249): The term intellectual disability or intellectual developmental disorder is used to describe significantly sub-average intellectual and adaptive functioning based on clinical assessment and as measured by individually administered, appropriately normed, standardized and validated tests of intellectual functioning and adaptive behavior, with onset during the developmental period from infancy through adolescence. Evidence: TAS. Frequency: Frequent (HP:0040282). (ORPHA:247262)
- Growth delay (HP:0001510): A deficiency or slowing down of growth pre- and postnatally. Evidence: TAS. Frequency: Frequent (HP:0040282). (ORPHA:247262)
- Abnormal facial shape (HP:0001999): An abnormal morphology (form) of the face or its components. Evidence: TAS. Frequency: Frequent (HP:0040282). (ORPHA:247262)
- Bilateral tonic-clonic seizure (HP:0002069): A bilateral tonic-clonic seizure is a seizure defined by a tonic (bilateral increased tone, lasting seconds to minutes) and then a clonic (bilateral sustained rhythmic jerking) phase. Evidence: TAS. Frequency: Frequent (HP:0040282). (ORPHA:247262)
- Downturned corners of mouth (HP:0002714): A morphological abnormality of the mouth in which the angle of the mouth is downturned. The oral commissures are positioned inferior to the midline labial fissure. Evidence: TAS. Frequency: Frequent (HP:0040282). (ORPHA:247262)
- Tented upper lip vermilion (HP:0010804): Triangular appearance of the oral aperture with the apex in the midpoint of the upper vermilion and the lower vermilion forming the base. Evidence: TAS. Frequency: Frequent (HP:0040282). (ORPHA:247262)
- Hydronephrosis (HP:0000126): Severe distention of the kidney with dilation of the renal pelvis and calices. Evidence: TAS. Frequency: Occasional (HP:0040283). (ORPHA:247262)
- Bifid uvula (HP:0000193): Uvula separated into two parts most easily seen at the tip. Evidence: TAS. Frequency: Occasional (HP:0040283). (ORPHA:247262)
- High palate (HP:0000218): Height of the palate more than 2 SD above the mean (objective) or palatal height at the level of the first permanent molar more than twice the height of the teeth (subjective). Evidence: TAS. Frequency: Occasional (HP:0040283). (ORPHA:247262)
- Brachycephaly (HP:0000248): An abnormality of skull shape characterized by a decreased anterior-posterior diameter. That is, a cephalic index greater than 81%. Alternatively, an apparently shortened anteroposterior dimension (length) of the head compared to width. Evidence: TAS. Frequency: Occasional (HP:0040283). (ORPHA:247262)
- Coarse facial features (HP:0000280): Absence of fine and sharp appearance of brows, nose, lips, mouth, and chin, usually because of rounded and heavy features or thickened skin with or without thickening of subcutaneous and bony tissues. Evidence: TAS. Frequency: Occasional (HP:0040283). (ORPHA:247262)
- Epicanthus (HP:0000286): A fold of skin starting above the medial aspect of the upper eyelid and arching downward to cover, pass in front of and lateral to the medial canthus. Evidence: TAS. Frequency: Occasional (HP:0040283). (ORPHA:247262)
- Broad philtrum (HP:0000289): Distance between the philtral ridges, measured just above the vermilion border, more than 2 standard deviations above the mean, or alternatively, an apparently increased distance between the ridges of the philtrum. Evidence: TAS. Frequency: Occasional (HP:0040283). (ORPHA:247262)
- Mandibular prognathia (HP:0000303): Abnormal prominence of the chin related to increased length of the mandible. Evidence: TAS. Frequency: Occasional (HP:0040283). (ORPHA:247262)
- Round face (HP:0000311): The facial appearance is more circular than usual as viewed from the front. Evidence: TAS. Frequency: Occasional (HP:0040283). (ORPHA:247262)
- Short philtrum (HP:0000322): Distance between nasal base and midline upper lip vermilion border more than 2 SD below the mean. Alternatively, an apparently decreased distance between nasal base and midline upper lip vermilion border. Evidence: TAS. Frequency: Occasional (HP:0040283). (ORPHA:247262)
- Micrognathia (HP:0000347): Developmental hypoplasia of the mandible. Evidence: TAS. Frequency: Occasional (HP:0040283). (ORPHA:247262)
- Cupped ear (HP:0000378): Laterally protruding ear that lacks antihelical folding (including absence of inferior and superior crura). Evidence: TAS. Frequency: Occasional (HP:0040283). (ORPHA:247262)
- Thickened helices (HP:0000391): Increased thickness of the helix of the ear. Evidence: TAS. Frequency: Occasional (HP:0040283). (ORPHA:247262)
- Bulbous nose (HP:0000414): Increased volume and globular shape of the anteroinferior aspect of the nose. Evidence: TAS. Frequency: Occasional (HP:0040283). (ORPHA:247262)
- Prominent nasal bridge (HP:0000426): Anterior positioning of the nasal root in comparison to the usual positioning for age. Evidence: TAS. Frequency: Occasional (HP:0040283). (ORPHA:247262)
- Short neck (HP:0000470): Diminished length of the neck. Evidence: TAS. Frequency: Occasional (HP:0040283). (ORPHA:247262)
- Hypermetropia (HP:0000540): An abnormality of refraction characterized by the ability to see objects in the distance clearly, while objects nearby appear blurry. Evidence: TAS. Frequency: Occasional (HP:0040283). (ORPHA:247262)
- Esotropia (HP:0000565): A form of strabismus with one or both eyes turned inward ('crossed') to a relatively severe degree, usually defined as 10 diopters or more. Evidence: TAS. Frequency: Occasional (HP:0040283). (ORPHA:247262)
- Upslanted palpebral fissure (HP:0000582): The palpebral fissure inclination is more than two standard deviations above the mean for age (objective); or, the inclination of the palpebral fissure is greater than typical for age. Evidence: TAS. Frequency: Occasional (HP:0040283). (ORPHA:247262)
- Shallow anterior chamber (HP:0000594): Reduced depth of the anterior chamber, i.e., the anteroposterior distance between the cornea and the iris is decreased. Evidence: TAS. Frequency: Occasional (HP:0040283). (ORPHA:247262)
- Oculomotor apraxia (HP:0000657): Ocular motor apraxia is a deficiency in voluntary, horizontal, lateral, fast eye movements (saccades) with retention of slow pursuit movements. The inability to follow objects visually is often compensated by head movements. There may be decreased smooth pursuit, and cancelation of the vestibulo-ocular reflex. Evidence: TAS. Frequency: Occasional (HP:0040283). (ORPHA:247262)
- Autistic behavior (HP:0000729): Persistent deficits in social interaction and communication and interaction as well as a markedly restricted repertoire of activity and interest as well as repetitive patterns of behavior. Evidence: TAS. Frequency: Occasional (HP:0040283). (ORPHA:247262)
- Pectus excavatum (HP:0000767): A defect of the chest wall characterized by a depression of the sternum, giving the chest ("pectus") a caved-in ("excavatum") appearance. Evidence: TAS. Frequency: Occasional (HP:0040283). (ORPHA:247262)
- Telangiectasia (HP:0001009): Telangiectasias refer to small dilated blood vessels located near the surface of the skin or mucous membranes, measuring between 0.5 and 1 millimeter in diameter. Telangiectasia are located especially on the tongue, lips, palate, fingers, face, conjunctiva, trunk, nail beds, and fingertips. Evidence: TAS. Frequency: Occasional (HP:0040283). (ORPHA:247262)
- Single umbilical artery (HP:0001195): Single umbilical artery (SUA) is the absence of one of the two umbilical arteries surrounding the fetal bladder and in the fetal umbilical cord. Evidence: TAS. Frequency: Occasional (HP:0040283). (ORPHA:247262)
- Ataxia (HP:0001251): Ataxia refers to impaired coordination of voluntary muscle movement. Cerebellar ataxia refers to ataxia due to dysfunction of the cerebellum. This causes a variety of elementary neurological deficits including asynergy (lack of coordination between muscles, limbs and joints), dysmetria (lack of ability to judge distances that can lead to under- or overshoot in grasping movements), and dysdiadochokinesia (inability to perform rapid movements requiring antagonizing muscle groups to be switched on and off repeatedly). Evidence: TAS. Frequency: Occasional (HP:0040283). (ORPHA:247262)
- Gait disturbance (HP:0001288): The term gait disturbance can refer to any disruption of the ability to walk. Evidence: TAS. Frequency: Occasional (HP:0040283). (ORPHA:247262)
- Diminished deep tendon reflex (HP:0001315): A reduction (hyporeflexia) or complete absence (areflexia) of the involuntary muscle contraction normally elicited by a reflex stimulus, such as tapping a deep tendon. Evidence: TAS. Frequency: Occasional (HP:0040283). (ORPHA:247262)
- Myoclonus (HP:0001336): Very brief, involuntary random muscular contractions occurring at rest, in response to sensory stimuli, or accompanying voluntary movements. Evidence: TAS. Frequency: Occasional (HP:0040283). (ORPHA:247262)
- Plagiocephaly (HP:0001357): Asymmetric head shape, which is usually a combination of unilateral occipital flattening with ipsilateral frontal prominence, leading to rhomboid cranial shape. Evidence: TAS. Frequency: Occasional (HP:0040283). (ORPHA:247262)
- Hip dysplasia (HP:0001385): The presence of developmental dysplasia of the hip. Evidence: TAS. Frequency: Occasional (HP:0040283). (ORPHA:247262)
- Anteriorly placed anus (HP:0001545): Anterior malposition of the anus. Evidence: TAS. Frequency: Occasional (HP:0040283). (ORPHA:247262)
- Oligohydramnios (HP:0001562): Diminished amniotic fluid volume in pregnancy. Evidence: TAS. Frequency: Occasional (HP:0040283). (ORPHA:247262)
- Small nail (HP:0001792): A nail that is diminished in length and width, i.e., underdeveloped nail. Evidence: TAS. Frequency: Occasional (HP:0040283). (ORPHA:247262)
- Aganglionic megacolon (HP:0002251): An abnormality resulting from a lack of intestinal ganglion cells (i.e., an aganglionic section of bowel) that results in bowel obstruction with enlargement of the colon. Evidence: TAS. Frequency: Occasional (HP:0040283). (ORPHA:247262)
- Moderate intellectual disability (HP:0002342): Moderate intellectual disability (ID) is defined as a type of ID characterized by moderately sub-average adaptive functioning and intellectual functioning, with an intelligence quotient (IQ) the range of 35-49. Evidence: TAS. Frequency: Occasional (HP:0040283). (ORPHA:247262)
- EEG with polyspike wave complexes (HP:0002392): The presence of complexes of repetitive spikes and waves in EEG. Evidence: TAS. Frequency: Occasional (HP:0040283). (ORPHA:247262)
- Highly arched eyebrow (HP:0002553): Increased height of the central portion of the eyebrow, forming a crescent, semicircular, or inverted U shape. Evidence: TAS. Frequency: Occasional (HP:0040283). (ORPHA:247262)
- Supernumerary nipple (HP:0002558): Presence of more than two nipples. Evidence: TAS. Frequency: Occasional (HP:0040283). (ORPHA:247262)
- Scoliosis (HP:0002650): The presence of an abnormal lateral curvature of the spine. Evidence: TAS. Frequency: Occasional (HP:0040283). (ORPHA:247262)
- Abnormal parietal bone morphology (HP:0002696): Any abnormality of the parietal bone of the skull. Evidence: TAS. Frequency: Occasional (HP:0040283). (ORPHA:247262)
- Cerebral hypomyelination (HP:0006808): Reduced amount of myelin in the nervous system resulting from defective myelinogenesis in the white matter of the central nervous system. Evidence: TAS. Frequency: Occasional (HP:0040283). (ORPHA:247262)
- EEG with spike-wave complexes (HP:0010850): Complexes of spikes (<70 ms) and sharp waves (70-200 ms), which are sharp transient waves that have a strong association with epilepsy, in cerebral electrical activity recorded along the scalp by electroencephalography (EEG). Evidence: TAS. Frequency: Occasional (HP:0040283). (ORPHA:247262)
- Severe intellectual disability (HP:0010864): Severe intellectual disability (ID) is defined as a type of ID characterized by severely sub-average adaptive functioning and intellectual functioning, with an intelligence quotient (IQ) the range of 20-34. Evidence: TAS. Frequency: Occasional (HP:0040283). (ORPHA:247262)
- Gastrostomy tube feeding in infancy (HP:0011471): Feeding problem necessitating gastrostomy tube feeding. Evidence: TAS. Frequency: Occasional (HP:0040283). (ORPHA:247262)
- Clinodactyly (HP:0030084): An angulation of a digit at an interphalangeal joint in the plane of the palm (finger) or sole (toe). Evidence: TAS. Frequency: Occasional (HP:0040283). (ORPHA:247262)
- Increased head circumference (HP:0040194): An abnormally increased head circumference in a growing child. Head circumference is measured with a nonelastic tape and comprises the distance from above the eyebrows and ears and around the back of the head. The measured HC is then plotted on an appropriate growth chart. Evidence: TAS. Frequency: Occasional (HP:0040283). (ORPHA:247262)
- Decreased head circumference (HP:0040195): An abnormally reduced head circumference in a growing child. Head circumference is measured with a nonelastic tape and comprises the distance from above the eyebrows and ears and around the back of the head. The measured HC is then plotted on an appropriate growth chart. Microcephaly is defined as a head circumference (HC) that is great than two standard deviations below the mean of age- and gender-matched population based samples. Severe microcephaly is defined with an HC that is three standard deviations below the mean. Evidence: TAS. Frequency: Occasional (HP:0040283). (ORPHA:247262)